Phenotypes associated with the disease Night blindness-skeletal anomalies-dysmorphism syndrome (ORPHA:1390):
- Joint hypermobility (HP:0001382): The capability that a joint (or a group of joints) has to move, passively and/or actively, beyond normal limits along physiological axes. Evidence: TAS. Frequency: Very frequent (HP:0040281). (ORPHA:1390)
- Abnormal palate morphology (HP:0000174): Any abnormality of the palate, i.e., of roof of the mouth. Evidence: TAS. Frequency: Very frequent (HP:0040281). (ORPHA:1390)
- Malar flattening (HP:0000272): Underdevelopment of the malar prominence of the jugal bone (zygomatic bone in mammals), appreciated in profile, frontal view, and/or by palpation. Evidence: TAS. Frequency: Very frequent (HP:0040281). (ORPHA:1390)
- Retrognathia (HP:0000278): An abnormality in which the mandible is mislocalised posteriorly. Evidence: TAS. Frequency: Very frequent (HP:0040281). (ORPHA:1390)
- Epicanthus (HP:0000286): A fold of skin starting above the medial aspect of the upper eyelid and arching downward to cover, pass in front of and lateral to the medial canthus. Evidence: TAS. Frequency: Very frequent (HP:0040281). (ORPHA:1390)
- Ptosis (HP:0000508): The upper eyelid margin is positioned 3 mm or more lower than usual and covers the superior portion of the iris (objective); or, the upper lid margin obscures at least part of the pupil (subjective). Evidence: TAS. Frequency: Very frequent (HP:0040281). (ORPHA:1390)
- Abnormal electroretinogram (HP:0000512): Any abnormality of the electrical responses of various cell types in the retina as measured by electroretinography. Evidence: TAS. Frequency: Very frequent (HP:0040281). (ORPHA:1390)
- Myopia (HP:0000545): An abnormality of refraction characterized by the ability to see objects nearby clearly, while objects in the distance appear blurry. Evidence: TAS. Frequency: Very frequent (HP:0040281). (ORPHA:1390)
- Nyctalopia (HP:0000662): Inability to see well at night or in poor light. Evidence: TAS. Frequency: Very frequent (HP:0040281). (ORPHA:1390)
- Synophrys (HP:0000664): Meeting of the medial eyebrows in the midline. Evidence: TAS. Frequency: Very frequent (HP:0040281). (ORPHA:1390)
- Carious teeth (HP:0000670): Caries is a multifactorial bacterial infection affecting the structure of the tooth. This term has been used to describe the presence of more than expected dental caries. Evidence: TAS. Frequency: Very frequent (HP:0040281). (ORPHA:1390)
- Brachydactyly (HP:0001156): Digits that appear disproportionately short compared to the hand/foot. The word brachydactyly is used here to describe a series distinct patterns of shortened digits (brachydactyly types A-E). This is the sense used here. Evidence: TAS. Frequency: Very frequent (HP:0040281). (ORPHA:1390)
- Abnormal retinal vascular morphology (HP:0008046): A structural abnormality of retinal vasculature. Evidence: TAS. Frequency: Very frequent (HP:0040281). (ORPHA:1390)
- Down-sloping shoulders (HP:0200021): Low set, steeply sloping shoulders. Evidence: TAS. Frequency: Very frequent (HP:0040281). (ORPHA:1390)
- Abnormality of the nose (HP:0000366): An abnormality of the nose. Evidence: TAS. Frequency: Frequent (HP:0040282). (ORPHA:1390)
- Downslanted palpebral fissures (HP:0000494): The palpebral fissure inclination is more than two standard deviations below the mean. Evidence: TAS. Frequency: Frequent (HP:0040282). (ORPHA:1390)
- Heterochromia iridis (HP:0001100): Heterochromia iridis is a difference in the color of the iris in the two eyes. Evidence: TAS. Frequency: Frequent (HP:0040282). (ORPHA:1390)
- Hypertonia (HP:0001276): A condition in which there is increased muscle tone so that arms or legs, for example, are stiff and difficult to move. Evidence: TAS. Frequency: Frequent (HP:0040282). (ORPHA:1390)
- Scoliosis (HP:0002650): The presence of an abnormal lateral curvature of the spine. Evidence: TAS. Frequency: Frequent (HP:0040282). (ORPHA:1390)
- Clinodactyly of the 5th finger (HP:0004209): Clinodactyly refers to a bending or curvature of the fifth finger in the radial direction (i.e., towards the 4th finger). Evidence: TAS. Frequency: Frequent (HP:0040282). (ORPHA:1390)
- Abnormal retinal pigmentation (HP:0007703): Any deviation from the normal pigmentation of the retina. Evidence: TAS. Frequency: Frequent (HP:0040282). (ORPHA:1390)
- Cognitive impairment (HP:0100543): Abnormal cognition is characterized by deficits in thinking, reasoning, or remembering. Evidence: TAS. Frequency: Frequent (HP:0040282). (ORPHA:1390)
- Posteriorly rotated ears (HP:0000358): A type of abnormal location of the ears in which the position of the ears is characterized by posterior rotation (the superior part of the ears is rotated towards the back of the head, and the inferior part of the ears towards the front). Evidence: TAS. Frequency: Frequent (HP:0040282). (ORPHA:1390)